Phenotypes associated with the disease cataract 22 multiple types (OMIM:609741):
- Nuclear cataract (HP:0100018): A nuclear cataract is an opacity or clouding that develops in the lens nucleus. That is, a nuclear cataract is one that is located in the center of the lens. The nucleus tends to darken changing from clear to yellow and sometimes brown. Evidence: TAS. Frequency: 6/6. Onset: Congenital onset (HP:0003577). (OMIM:609741)
- Congenital onset (HP:0003577): A phenotypic abnormality that is present at birth. Evidence: PCS. Frequency: 6/6. (PMID:15914629)
- Developmental cataract (HP:0000519): A cataract that occurs congenitally as the result of a developmental defect, in contrast to the majority of cataracts that occur in adulthood as the result of degenerative changes of the lens. Evidence: TAS. (OMIM:609741)
- Autosomal recessive inheritance (HP:0000007): A mode of inheritance that is observed for traits related to a gene encoded on one of the autosomes (i.e., the human chromosomes 1-22) in which a trait manifests in individuals with two pathogenic alleles, either homozygotes (two copies of the same mutant allele) or compound heterozygotes (whereby each copy of a gene has a distinct mutant allele). Evidence: PCS. (PMID:15914629)
- Glaucoma (HP:0000501): Glaucoma refers loss of retinal ganglion cells in a characteristic pattern of optic neuropathy usually associated with increased intraocular pressure. Evidence: TAS. Frequency: Occasional (HP:0040283). (OMIM:609741)
- Autosomal dominant inheritance (HP:0000006): A mode of inheritance that is observed for traits related to a gene encoded on one of the autosomes (i.e., the human chromosomes 1-22) in which a trait manifests in heterozygotes. In the context of medical genetics, an autosomal dominant disorder is caused when a single copy of the mutant allele is present. Males and females are affected equally, and can both transmit the disorder with a risk of 50% for each child of inheriting the mutant allele. Evidence: TAS. (OMIM:609741)